Phenotypes associated with the disease Faciocardiorenal syndrome (ORPHA:1973):
- Horseshoe kidney (HP:0000085): A connection of the right and left kidney by an isthmus of functioning renal parenchyma or fibrous tissue that crosses the midline. Evidence: TAS. Frequency: Very frequent (HP:0040281). (ORPHA:1973)
- Narrow mouth (HP:0000160): Distance between the commissures of the mouth more than 2 SD below the mean. Alternatively, an apparently decreased width of the oral aperture (subjective). Evidence: TAS. Frequency: Occasional (HP:0040283). (ORPHA:1973)
- Cleft palate (HP:0000175): Cleft palate is a developmental defect of the palate resulting from a failure of fusion of the palatine processes and manifesting as a separation of the roof of the mouth (soft and hard palate). Evidence: TAS. Frequency: Very frequent (HP:0040281). (ORPHA:1973)
- Hypertelorism (HP:0000316): Interpupillary distance more than 2 SD above the mean (alternatively, the appearance of an increased interpupillary distance or widely spaced eyes). Evidence: TAS. Frequency: Very frequent (HP:0040281). (ORPHA:1973)
- Smooth philtrum (HP:0000319): Flat skin surface, with no ridge formation in the central region of the upper lip between the nasal base and upper vermilion border. Evidence: TAS. Frequency: Very frequent (HP:0040281). (ORPHA:1973)
- Protruding ear (HP:0000411): Angle formed by the plane of the ear and the mastoid bone greater than the 97th centile for age (objective); or, outer edge of the helix more than 2 cm from the mastoid at the point of maximum distance (objective). Evidence: TAS. Frequency: Very frequent (HP:0040281). (ORPHA:1973)
- Underdeveloped nasal alae (HP:0000430): Thinned, deficient, or excessively arched ala nasi. Evidence: TAS. Frequency: Very frequent (HP:0040281). (ORPHA:1973)
- Wide nasal bridge (HP:0000431): Increased breadth of the nasal bridge (and with it, the nasal root). Evidence: TAS. Frequency: Very frequent (HP:0040281). (ORPHA:1973)
- Hypodontia (HP:0000668): The absence of five or less teeth from the normal series by a failure to develop. Evidence: TAS. Frequency: Very frequent (HP:0040281). (ORPHA:1973)
- Intellectual disability (HP:0001249): The term intellectual disability or intellectual developmental disorder is used to describe significantly sub-average intellectual and adaptive functioning based on clinical assessment and as measured by individually administered, appropriately normed, standardized and validated tests of intellectual functioning and adaptive behavior, with onset during the developmental period from infancy through adolescence. Evidence: TAS. Frequency: Very frequent (HP:0040281). (ORPHA:1973)
- Plagiocephaly (HP:0001357): Asymmetric head shape, which is usually a combination of unilateral occipital flattening with ipsilateral frontal prominence, leading to rhomboid cranial shape. Evidence: TAS. Frequency: Very frequent (HP:0040281). (ORPHA:1973)
- Failure to thrive (HP:0001508): Failure to thrive (FTT) refers to a child whose physical growth is substantially below the norm. Evidence: TAS. Frequency: Occasional (HP:0040283). (ORPHA:1973)
- Tricuspid valve prolapse (HP:0001704): One or more of the leaflets (cusps) of the tricuspid valve bulges back into the right atrium upon contraction of the right ventricle. Evidence: TAS. Frequency: Occasional (HP:0040283). (ORPHA:1973)
- Endocardial fibroelastosis (HP:0001706): Diffuse thickening of the ventricular endocardium and by associated myocardial dysfunction. Evidence: TAS. Frequency: Frequent (HP:0040282). (ORPHA:1973)